Phenotypes associated with the disease pulmonary hypertension, primary, 4 (OMIM:615344):
- Progressive (HP:0003676): Applies to a disease manifestation that increases in scope or severity over the course of time, i.e., that worsens with age. Evidence: PCS. (PMID:23883380)
- Juvenile onset (HP:0003621): Onset of signs or symptoms of disease between the age of 5 and 15 years. Evidence: PCS. Frequency: 1/7. (PMID:23883380)
- Middle age onset (HP:0003596): A type of adult onset with onset of symptoms at the age of 40 to 60 years. Evidence: PCS. Frequency: 1/7. (PMID:23883380)
- First degree atrioventricular block (HP:0011705): Delay of conduction through the atrioventricular node, which is manifested as prolongation of the PR interval in the electrocardiogram (EKG). All atrial impulses reach the ventricles. Evidence: PCS. Frequency: 1/9. (PMID:23883380)
- Elevated pulmonary artery pressure (HP:0004890): An abnormally elevated blood pressure in the circulation of the pulmonary artery. Evidence: PCS. Frequency: 7/9. (PMID:23883380)
- Complete right bundle branch block (HP:0011712): A conduction block of the right branch of the bundle of His. This manifests as a prolongation of the QRS complex (greater than 0.12 s) with delayed activation of the right ventricle and terminal delay on the EKG. Evidence: PCS. Frequency: 2/9. (PMID:23883380)
- Pulmonary arterial hypertension (HP:0002092): Pulmonary hypertension is defined mean pulmonary artery pressure of 25mmHg or more and pulmonary capillary wedge pressure of 15mmHg or less when measured by right heart catheterisation at rest and in a supine position. Evidence: PCS. Frequency: 7/9. (PMID:23883380)
- Pulmonary arterial hypertension with lack of acute response to NO challenge (HP:0033424): A form of pulmonary arterial hypertension with lack of adequate hemodynamic response to NO challenge (adequate response is defined as a reduction of mean pulmonary artery pressure (mPAP) of at least 10 mmHg to reach an absolute value of mPAP 40 mmHg or less with an increased or unchanged cardiac output (CO) in response to inhaled nitric oxide at 10-20 ppm). Evidence: PCS. Frequency: 5/5. (PMID:23883380)
- Thromboembolism (HP:0001907): The formation of a blood clot inside a blood vessel that subsequently travels through the blood stream from the site where it formed to another location in the body, generally leading to vascular occlusion at the distant site. Evidence: PCS. Frequency: 0/9. (PMID:23883380)
- Young adult onset (HP:0011462): Onset of disease at the age of between 16 and 40 years. Evidence: PCS. Frequency: 5/7. (PMID:23883380)
- Atrial flutter (HP:0004749): A type of atrial arrhythmia characterized by atrial rates of between 240 and 400 beats per minute and some degree of atrioventricular node conduction block. Typically, the ventricular rate is half the atrial rate. In the EKG; atrial flutter waves are observed as sawtooth-like atrial activity. Pathophysiologically, atrial flutter is a form of atrial reentry in which there is a premature electrical impulse creates a self-propagating circuit. Evidence: PCS. Frequency: 1/9. (PMID:23883380)
- Autosomal dominant inheritance (HP:0000006): A mode of inheritance that is observed for traits related to a gene encoded on one of the autosomes (i.e., the human chromosomes 1-22) in which a trait manifests in heterozygotes. In the context of medical genetics, an autosomal dominant disorder is caused when a single copy of the mutant allele is present. Males and females are affected equally, and can both transmit the disorder with a risk of 50% for each child of inheriting the mutant allele. Evidence: PCS. (PMID:23883380)
- Increased pulmonary vascular resistance (HP:0005317): Pulmonary vascular resistance (PVR) more than 3 wood units, as defined by the current definition of pulmonary hypertension. 95% of individuals have a PVR of less than 2.4 wood units. Evidence: PCS. (PMID:23883380)